Phenotypes associated with the disease autosomal recessive nonsyndromic hearing loss 8 (OMIM:601072):
- Congenital onset (HP:0003577): A phenotypic abnormality that is present at birth. Evidence: PCS. (PMID:11137999)
- Sensorineural hearing impairment (HP:0000407): A type of hearing impairment in one or both ears related to an abnormal functionality of the cochlear nerve. Evidence: PCS. (PMID:11137999)
- Childhood onset (HP:0011463): Onset of disease at the age of between 1 and 5 years. Evidence: PCS. (PMID:11137999)
- Autosomal recessive inheritance (HP:0000007): A mode of inheritance that is observed for traits related to a gene encoded on one of the autosomes (i.e., the human chromosomes 1-22) in which a trait manifests in individuals with two pathogenic alleles, either homozygotes (two copies of the same mutant allele) or compound heterozygotes (whereby each copy of a gene has a distinct mutant allele). Evidence: PCS. (PMID:11137999)